- Cerebellar vermis hypoplasia (HP:0001320): Underdevelopment of the vermis of cerebellum. Evidence: PCS. Frequency: 5/6. (PMID:31168944)
- Gaze-evoked horizontal nystagmus (HP:0007979): Horizontal nystagmus made apparent by looking to the right or to the left. Evidence: PCS. (PMID:31168944)
- Mild intellectual disability (HP:0001256): Mild intellectual disability (ID) is defined as a type of ID characterized by mildly sub-average adaptive functioning and intellectual functioning, with an intelligence quotient (IQ) the range of 50-69. Evidence: PCS. (PMID:31168944)
- Strabismus (HP:0000486): A misalignment of the eyes so that the visual axes deviate from bifoveal fixation. The classification of strabismus may be based on a number of features including the relative position of the eyes, whether the deviation is latent or manifest, intermittent or constant, concomitant or otherwise and according to the age of onset and the relevance of any associated refractive error. Evidence: PCS. Frequency: 1/3. (PMID:31168944)
- Short stature (HP:0004322): A height below that which is expected according to age and gender norms. Although there is no universally accepted definition of short stature, many refer to "short stature" as height more than 2 standard deviations below the mean for age and gender (or below the 3rd percentile for age and gender dependent norms). Evidence: PCS. (PMID:31168944)
- Truncal titubation (HP:0030147): Tremor of the trunk in an anterior-posterior plane at 3-4 Hz. Evidence: PCS. Frequency: 1/6. (PMID:31168944)
- Gait ataxia (HP:0002066): A type of ataxia characterized by the impairment of the ability to coordinate the movements required for normal walking. Gait ataxia is characteirzed by a wide-based staggering gait with a tendency to fall. Evidence: PCS. (PMID:31168944)
- Dysarthria (HP:0001260): Dysarthric speech is a general description referring to a neurological speech disorder characterized by poor articulation. Depending on the involved neurological structures, dysarthria may be further classified as spastic, flaccid, ataxic, hyperkinetic and hypokinetic, or mixed. Evidence: PCS. Frequency: 5/5. (PMID:31168944)
- Motor delay (HP:0001270): A type of Developmental delay characterized by a delay in acquiring motor skills. Evidence: PCS. Frequency: 5/5. (PMID:31168944)
- Poor fine motor coordination (HP:0007010): An abnormality of the ability (skills) to perform a precise movement of small muscles with the intent to perform a specific act. Fine motor skills are required to mediate movements of the wrists, hands, fingers, feet, and toes. Evidence: PCS. (PMID:31168944)
- Impaired smooth pursuit (HP:0007772): An impairment of the ability to track objects with the ocular smooth pursuit system, a class of rather slow eye movements that minimizes retinal target motion. Evidence: PCS. (PMID:31168944)
- Autosomal recessive inheritance (HP:0000007): A mode of inheritance that is observed for traits related to a gene encoded on one of the autosomes (i.e., the human chromosomes 1-22) in which a trait manifests in individuals with two pathogenic alleles, either homozygotes (two copies of the same mutant allele) or compound heterozygotes (whereby each copy of a gene has a distinct mutant allele). Evidence: PCS. (PMID:31168944)
- Abnormal pyramidal sign (HP:0007256): Functional neurological abnormalities related to dysfunction of the pyramidal tract. Evidence: PCS. Frequency: 4/5. (PMID:31168944)
- Optic atrophy (HP:0000648): Atrophy of the optic nerve. Optic atrophy results from the death of the retinal ganglion cell axons that comprise the optic nerve and manifesting as a pale optic nerve on fundoscopy. Evidence: PCS. Frequency: 1/3. (PMID:31168944)
- Myopia (HP:0000545): An abnormality of refraction characterized by the ability to see objects nearby clearly, while objects in the distance appear blurry. Evidence: PCS. (PMID:31168944)
These phenotypes are associated with the disease spinocerebellar ataxia, autosomal recessive 28 (OMIM:618800).